- Hydrocephalus (HP:0000238): Hydrocephalus is an active distension of the ventricular system of the brain resulting from inadequate passage of CSF from its point of production within the cerebral ventricles to its point of absorption into the systemic circulation. Evidence: TAS. Frequency: Occasional (HP:0040283). (ORPHA:1946)
- Hypohidrosis (HP:0000966): Abnormally diminished capacity to sweat. Evidence: TAS. Frequency: Frequent (HP:0040282). (ORPHA:1946)
- Seizure (HP:0001250): A seizure is an intermittent abnormality of nervous system physiology characterized by a transient occurrence of signs and/or symptoms due to abnormal excessive or synchronous neuronal activity in the brain. Evidence: TAS. Frequency: Very frequent (HP:0040281). (ORPHA:1946)
- Spasticity (HP:0001257): A motor disorder characterized by a velocity-dependent increase in tonic stretch reflexes with increased muscle tone, exaggerated (hyperexcitable) tendon reflexes. Evidence: TAS. Frequency: Very frequent (HP:0040281). (ORPHA:1946)
- Mental deterioration (HP:0001268): Loss of previously present mental abilities, generally in adults. Evidence: TAS. Frequency: Very frequent (HP:0040281). (ORPHA:1946)
- EEG abnormality (HP:0002353): Abnormality observed by electroencephalogram (EEG), which is used to record of the brain's spontaneous electrical activity from multiple electrodes placed on the scalp. Evidence: TAS. Frequency: Very frequent (HP:0040281). (ORPHA:1946)
- Developmental regression (HP:0002376): Loss of developmental skills, as manifested by loss of developmental milestones. Evidence: TAS. Frequency: Very frequent (HP:0040281). (ORPHA:1946)
- Short stature (HP:0004322): A height below that which is expected according to age and gender norms. Although there is no universally accepted definition of short stature, many refer to "short stature" as height more than 2 standard deviations below the mean for age and gender (or below the 3rd percentile for age and gender dependent norms). Evidence: TAS. Frequency: Occasional (HP:0040283). (ORPHA:1946)
- Yellow-brown discoloration of the teeth (HP:0006286). Evidence: TAS. Frequency: Very frequent (HP:0040281). (ORPHA:1946)
- Abnormality of dental color (HP:0011073): A developmental defect of tooth color. Evidence: TAS. Frequency: Very frequent (HP:0040281). (ORPHA:1946)
- Abnormal dental enamel morphology (HP:0000682): An abnormality of the dental enamel. Evidence: TAS. Frequency: Very frequent (HP:0040281). (ORPHA:1946)
- Amelogenesis imperfecta (HP:0000705): A developmental dysplasia of the dental enamel. Evidence: TAS. Frequency: Very frequent (HP:0040281). (ORPHA:1946)
- Dementia (HP:0000726): A loss of global cognitive ability of sufficient amount to interfere with normal social or occupational function. Dementia represents a loss of previously present cognitive abilities, generally in adults, and can affect memory, thinking, language, judgment, and behavior. Evidence: TAS. Frequency: Very frequent (HP:0040281). (ORPHA:1946)
- Severe intellectual disability (HP:0010864): Severe intellectual disability (ID) is defined as a type of ID characterized by severely sub-average adaptive functioning and intellectual functioning, with an intelligence quotient (IQ) the range of 20-34. Evidence: TAS. Frequency: Very frequent (HP:0040281). (ORPHA:1946)
These phenotypes are associated with the disease Amelocerebrohypohidrotic syndrome (ORPHA:1946).